Phenotypes associated with the disease Somatostatinoma (ORPHA:97283):
- Diabetes mellitus (HP:0000819): A group of abnormalities characterized by hyperglycemia and glucose intolerance. Evidence: TAS. Frequency: Frequent (HP:0040282). (ORPHA:97283)
- Weight loss (HP:0001824): Reduction of total body weight. Evidence: TAS. Frequency: Frequent (HP:0040282). (ORPHA:97283)
- Diarrhea (HP:0002014): Abnormally increased frequency (usually defined as three or more) loose or watery bowel movements a day. Evidence: TAS. Frequency: Frequent (HP:0040282). (ORPHA:97283)
- Nausea and vomiting (HP:0002017): Nausea is a commonly encountered symptom that has been defined as an unpleasant painless subjective feeling that one will imminently vomit. Vomiting has been defined as the forceful expulsion of the contents of the stomach, duodenum, or jejunum through the oral cavity. While nausea and vomiting are often thought to exist on a temporal continuum, this is not always the case. There are situations when severe nausea may be present without emesis and less frequently, when emesis may be present without preceding nausea. Evidence: TAS. Frequency: Frequent (HP:0040282). (ORPHA:97283)
- Constipation (HP:0002019): Infrequent or difficult evacuation of feces. Evidence: TAS. Frequency: Frequent (HP:0040282). (ORPHA:97283)
- Anorexia (HP:0002039): Lack of desire to eat (loss of appetite). Evidence: TAS. Frequency: Frequent (HP:0040282). (ORPHA:97283)
- Hepatomegaly (HP:0002240): Abnormally increased size of the liver. Evidence: TAS. Frequency: Frequent (HP:0040282). (ORPHA:97283)
- Steatorrhea (HP:0002570): Greater than normal amounts of fat in the feces. This is a result of malabsorption of lipids in the small intestine and results in frothy foul-smelling fecal matter that floats. Evidence: TAS. Frequency: Frequent (HP:0040282). (ORPHA:97283)
- Episodic abdominal pain (HP:0002574): An intermittent form of abdominal pain. Evidence: TAS. Frequency: Frequent (HP:0040282). (ORPHA:97283)
- Neoplasm of the pancreas (HP:0002894): A tumor (abnormal growth of tissue) of the pancreas. Evidence: TAS. Frequency: Frequent (HP:0040282). (ORPHA:97283)
- Poor appetite (HP:0004396): A reduced desire to eat. Evidence: TAS. Frequency: Frequent (HP:0040282). (ORPHA:97283)
- Hypochromic microcytic anemia (HP:0004840): A type of anemia characterized by an abnormally low concentration of hemoglobin in the erythrocytes and lower than normal size of the erythrocytes. Evidence: TAS. Frequency: Frequent (HP:0040282). (ORPHA:97283)
- Gallbladder dysfunction (HP:0005609). Evidence: TAS. Frequency: Frequent (HP:0040282). (ORPHA:97283)
- Chronic fatigue (HP:0012432): Subjective feeling of tiredness characterized by a lack of energy and motivation that persists for six months or longer. Evidence: TAS. Frequency: Frequent (HP:0040282). (ORPHA:97283)
- Neoplasm of the small intestine (HP:0100833): The presence of a neoplasm of the small intestine. Evidence: TAS. Frequency: Frequent (HP:0040282). (ORPHA:97283)
- Intermittent jaundice (HP:0001046): Jaundice that is sometimes present, sometimes not. Evidence: TAS. Frequency: Occasional (HP:0040283). (ORPHA:97283)
- Intrahepatic cholestasis (HP:0001406): Impairment of bile flow due to obstruction in the small bile ducts within the liver. Evidence: TAS. Frequency: Occasional (HP:0040283). (ORPHA:97283)
- Abnormal abdomen morphology (HP:0001438): A structural abnormality of the abdomen ('belly'), that is, the part of the body between the pelvis and the thorax. Evidence: TAS. Frequency: Occasional (HP:0040283). (ORPHA:97283)
- Ascites (HP:0001541): Accumulation of fluid in the peritoneal cavity (between the layers of the peritoneum that lines the abdomen). Evidence: TAS. Frequency: Occasional (HP:0040283). (ORPHA:97283)
- Gastrointestinal hemorrhage (HP:0002239): Hemorrhage affecting the gastrointestinal tract. Evidence: TAS. Frequency: Occasional (HP:0040283). (ORPHA:97283)
- Intestinal obstruction (HP:0005214): Blockage or impairment of the normal flow of the contents of the intestine towards the anal canal. Evidence: TAS. Frequency: Occasional (HP:0040283). (ORPHA:97283)
- Extrahepatic cholestasis (HP:0012334): Impairment of bile flow due to obstruction in large bile ducts outside the liver. Evidence: TAS. Frequency: Occasional (HP:0040283). (ORPHA:97283)
- Lack of bowel sounds (HP:0030145): Complete lack of abdominal sounds as assayed by examination of the abdomen with a stethoscope. Evidence: TAS. Frequency: Occasional (HP:0040283). (ORPHA:97283)
- Abnormality of the thyroid gland (HP:0000820): An abnormality of the thyroid gland. Evidence: TAS. Frequency: Very rare (HP:0040284). (ORPHA:97283)
- Increased circulating gonadotropin level (HP:0000837): Overproduction of gonadotropins (FSH, LH) by the anterior pituitary gland. Evidence: TAS. Frequency: Very rare (HP:0040284). (ORPHA:97283)
- Elevated circulating growth hormone concentration (HP:0000845): Acromegaly is a condition resulting from overproduction of growth hormone by the pituitary gland in persons with closed epiphyses, and consists chiefly in the enlargement of the distal parts of the body. The circumference of the skull increases, the nose becomes broad, the tongue becomes enlarged, the facial features become coarsened, the mandible grows excessively, and the teeth become separated. The fingers and toes grow chiefly in thickness. Evidence: TAS. Frequency: Very rare (HP:0040284). (ORPHA:97283)
- Increased circulating prolactin concentration (HP:0000870): The presence of abnormally increased levels of prolactin in the blood. Prolactin is a peptide hormone produced by the anterior pituitary gland that plays a role in breast development and lactation during pregnancy. Evidence: TAS. Frequency: Very rare (HP:0040284). (ORPHA:97283)
- Subcutaneous lipoma (HP:0001031): The presence of subcutaneous lipoma. Evidence: TAS. Frequency: Very rare (HP:0040284). (ORPHA:97283)
- Medullary thyroid carcinoma (HP:0002865): The presence of a medullary carcinoma of the thyroid gland. Evidence: TAS. Frequency: Very rare (HP:0040284). (ORPHA:97283)
- Pituitary adenoma (HP:0002893): A benign epithelial tumor derived from intrinsic cells of the adenohypophysis (anterior pituitary). Evidence: TAS. Frequency: Very rare (HP:0040284). (ORPHA:97283)
- Parathyroid adenoma (HP:0002897): A benign tumor of the parathyroid gland that can cause hyperparathyroidism. Evidence: TAS. Frequency: Very rare (HP:0040284). (ORPHA:97283)
- Hypercalcemia (HP:0003072): The concentration of calcium in the blood circulation is above the upper limit of normal. Evidence: TAS. Frequency: Very rare (HP:0040284). (ORPHA:97283)
- Increased circulating cortisol level (HP:0003118): Overproduction of the hormone of cortisol by the adrenal cortex, resulting in a characteristic combination of clinical symptoms termed Cushing syndrome, with truncal obesity, a round, full face, striae atrophicae and acne, muscle weakness, and other features. Evidence: TAS. Frequency: Very rare (HP:0040284). (ORPHA:97283)
- Primary hyperparathyroidism (HP:0008200): A type of hyperparathyroidism caused by a primary abnormality of the parathyroid glands (e.g., adenoma, carcinoma, hyperplasia). Primary hyperparathyroidism is associated with hyercalcemia. Evidence: TAS. Frequency: Very rare (HP:0040284). (ORPHA:97283)
- Adrenocortical adenoma (HP:0008256): Adrenocortical adenomas are benign tumors of the adrenal cortex. Evidence: TAS. Frequency: Very rare (HP:0040284). (ORPHA:97283)